- Kyphoscoliosis (HP:0002751): An abnormal curvature of the spine in both a coronal (lateral) and sagittal (back-to-front) plane. Evidence: PCS. Frequency: 1/6. (PMID:34413497)
- Microcephaly (HP:0000252): Head circumference below 2 standard deviations below the mean for age and gender. Evidence: PCS. Frequency: 6/6. (PMID:34413497)
- Mild intellectual disability (HP:0001256): Mild intellectual disability (ID) is defined as a type of ID characterized by mildly sub-average adaptive functioning and intellectual functioning, with an intelligence quotient (IQ) the range of 50-69. Evidence: PCS. Frequency: 5/6. (PMID:34413497)
- Strabismus (HP:0000486): A misalignment of the eyes so that the visual axes deviate from bifoveal fixation. The classification of strabismus may be based on a number of features including the relative position of the eyes, whether the deviation is latent or manifest, intermittent or constant, concomitant or otherwise and according to the age of onset and the relevance of any associated refractive error. Evidence: PCS. Frequency: 1/6. (PMID:34413497)
- Delayed skeletal maturation (HP:0002750): A decreased rate of skeletal maturation. Delayed skeletal maturation can be diagnosed on the basis of an estimation of the bone age from radiographs of specific bones in the human body. Evidence: PCS. Frequency: 1/6. (PMID:34413497)
- Brachydactyly (HP:0001156): Digits that appear disproportionately short compared to the hand/foot. The word brachydactyly is used here to describe a series distinct patterns of shortened digits (brachydactyly types A-E). This is the sense used here. Evidence: PCS. Frequency: 1/6. (PMID:34413497)
- Febrile seizure (within the age range of 3 months to 6 years) (HP:0002373): A febrile seizure is any type of seizure (most often a generalized tonic-clonic seizure) occurring with fever (at least 38 degrees Celsius) but in the absence of central nervous system infection, severe metabolic disturbance or other alternative precipitant in children between the ages of 3 months and 6 years. Evidence: PCS. Frequency: 1/6. (PMID:34413497)
- Asthma (HP:0002099): Asthma is characterized by increased responsiveness of the tracheobronchial tree to multiple stimuli, leading to narrowing of the air passages with resultant dyspnea, cough, and wheezing. Evidence: PCS. Frequency: 1/6. (PMID:34413497)
- Hypopigmentation of the skin (HP:0001010): A reduction of skin color related to a decrease in melanin production and deposition. Evidence: PCS. Frequency: 1/6. (PMID:34413497)
- Severe intellectual disability (HP:0010864): Severe intellectual disability (ID) is defined as a type of ID characterized by severely sub-average adaptive functioning and intellectual functioning, with an intelligence quotient (IQ) the range of 20-34. Evidence: PCS. Frequency: 1/6. (PMID:34413497)
- Nystagmus (HP:0000639): Rhythmic, involuntary oscillations of one or both eyes related to abnormality in fixation, conjugate gaze, or vestibular mechanisms. Evidence: PCS. Frequency: 1/6. (PMID:34413497)
- Microretrognathia (HP:0000308): A form of developmental hypoplasia of the mandible in which the mandible is mislocalised posteriorly. Evidence: PCS. Frequency: 2/6. (PMID:34413497)
- Sensorineural hearing impairment (HP:0000407): A type of hearing impairment in one or both ears related to an abnormal functionality of the cochlear nerve. Evidence: PCS. Frequency: 1/6. (PMID:34413497)
- Pectus excavatum (HP:0000767): A defect of the chest wall characterized by a depression of the sternum, giving the chest ("pectus") a caved-in ("excavatum") appearance. Evidence: PCS. Frequency: 1/6. (PMID:34413497)
- Autosomal recessive inheritance (HP:0000007): A mode of inheritance that is observed for traits related to a gene encoded on one of the autosomes (i.e., the human chromosomes 1-22) in which a trait manifests in individuals with two pathogenic alleles, either homozygotes (two copies of the same mutant allele) or compound heterozygotes (whereby each copy of a gene has a distinct mutant allele). Evidence: PCS. (PMID:34413497)
- Cubitus valgus (HP:0002967): Abnormal positioning in which the elbows are turned out. Evidence: PCS. Frequency: 2/6. (PMID:34413497)
- Clinodactyly of the 5th finger (HP:0004209): Clinodactyly refers to a bending or curvature of the fifth finger in the radial direction (i.e., towards the 4th finger). Evidence: PCS. Frequency: 1/6. (PMID:34413497)
- High palate (HP:0000218): Height of the palate more than 2 SD above the mean (objective) or palatal height at the level of the first permanent molar more than twice the height of the teeth (subjective). Evidence: PCS. Frequency: 2/6. (PMID:34413497)
- Narrow chest (HP:0000774): Reduced width of the chest from side to side, associated with a reduced distance from the sternal notch to the tip of the shoulder. Evidence: PCS. Frequency: 2/6. (PMID:34413497)
- Retrognathia (HP:0000278): An abnormality in which the mandible is mislocalised posteriorly. Evidence: PCS. Frequency: 1/6. (PMID:34413497)
- Optic neuropathy (HP:0001138). Evidence: PCS. Frequency: 2/6. (PMID:34413497)
- Exotropia (HP:0000577): A form of strabismus with one or both eyes deviated outward. Evidence: PCS. Frequency: 1/6. (PMID:34413497)
These phenotypes are associated with the disease intellectual developmental disorder, autosomal recessive 78 (OMIM:620237).